Phenotypes associated with the disease Early-onset epilepsy-intellectual disability-brain anomalies syndrome (ORPHA:488635):
- Seizure (HP:0001250): A seizure is an intermittent abnormality of nervous system physiology characterized by a transient occurrence of signs and/or symptoms due to abnormal excessive or synchronous neuronal activity in the brain. Evidence: TAS. Frequency: Very frequent (HP:0040281). (ORPHA:488635)
- Hypotonia (HP:0001252): Hypotonia is an abnormally low muscle tone (the amount of tension or resistance to movement in a muscle). Even when relaxed, muscles have a continuous and passive partial contraction which provides some resistance to passive stretching. Hypotonia thus manifests as diminished resistance to passive stretching. Hypotonia is not the same as muscle weakness, although the two conditions can co-exist. Evidence: TAS. Frequency: Very frequent (HP:0040281). (ORPHA:488635)
- Severe global developmental delay (HP:0011344): A severe delay in the achievement of motor or mental milestones in the domains of development of a child. Evidence: TAS. Frequency: Very frequent (HP:0040281). (ORPHA:488635)
- Delayed speech and language development (HP:0000750): A degree of language development that is significantly below the norm for a child of a specified age. Evidence: TAS. Frequency: Frequent (HP:0040282). (ORPHA:488635)
- Hyporeflexia (HP:0001265): Reduction of neurologic reflexes such as the knee-jerk reaction. Evidence: TAS. Frequency: Frequent (HP:0040282). (ORPHA:488635)
- Cerebellar hypoplasia (HP:0001321): Cerebellar hypoplasia is a descriptive term implying a cerebellum with a reduced volume, but a normal shape and is stable over time. Evidence: TAS. Frequency: Frequent (HP:0040282). (ORPHA:488635)
- Joint hypermobility (HP:0001382): The capability that a joint (or a group of joints) has to move, passively and/or actively, beyond normal limits along physiological axes. Evidence: TAS. Frequency: Frequent (HP:0040282). (ORPHA:488635)
- Growth delay (HP:0001510): A deficiency or slowing down of growth pre- and postnatally. Evidence: TAS. Frequency: Frequent (HP:0040282). (ORPHA:488635)
- Abnormal facial shape (HP:0001999): An abnormal morphology (form) of the face or its components. Evidence: TAS. Frequency: Frequent (HP:0040282). (ORPHA:488635)
- Gait ataxia (HP:0002066): A type of ataxia characterized by the impairment of the ability to coordinate the movements required for normal walking. Gait ataxia is characteirzed by a wide-based staggering gait with a tendency to fall. Evidence: TAS. Frequency: Frequent (HP:0040282). (ORPHA:488635)
- Hypoplasia of the corpus callosum (HP:0002079): Underdevelopment of the corpus callosum. Evidence: TAS. Frequency: Frequent (HP:0040282). (ORPHA:488635)
- Gait imbalance (HP:0002141). Evidence: TAS. Frequency: Frequent (HP:0040282). (ORPHA:488635)
- Abnormal lateral ventricle morphology (HP:0030047): A morphological anomaly of the lateral ventricle. Evidence: TAS. Frequency: Frequent (HP:0040282). (ORPHA:488635)
- Delayed ability to walk (HP:0031936): A failure to achieve the ability to walk at an appropriate developmental stage. Most children learn to walk in a series of stages, and learn to walk short distances independently between 12 and 15 months. Evidence: TAS. Frequency: Frequent (HP:0040282). (ORPHA:488635)
- Thin upper lip vermilion (HP:0000219): Height of the vermilion of the upper lip in the midline more than 2 SD below the mean. Alternatively, an apparently reduced height of the vermilion of the upper lip in the frontal view (subjective). Evidence: TAS. Frequency: Occasional (HP:0040283). (ORPHA:488635)
- Hypertelorism (HP:0000316): Interpupillary distance more than 2 SD above the mean (alternatively, the appearance of an increased interpupillary distance or widely spaced eyes). Evidence: TAS. Frequency: Occasional (HP:0040283). (ORPHA:488635)
- Wide nose (HP:0000445): Interalar distance more than two standard deviations above the mean for age, i.e., an apparently increased width of the nasal base and alae. Evidence: TAS. Frequency: Occasional (HP:0040283). (ORPHA:488635)
- Hypermetropia (HP:0000540): An abnormality of refraction characterized by the ability to see objects in the distance clearly, while objects nearby appear blurry. Evidence: TAS. Frequency: Occasional (HP:0040283). (ORPHA:488635)
- Autistic behavior (HP:0000729): Persistent deficits in social interaction and communication and interaction as well as a markedly restricted repertoire of activity and interest as well as repetitive patterns of behavior. Evidence: TAS. Frequency: Occasional (HP:0040283). (ORPHA:488635)
- Hyperextensibility of the finger joints (HP:0001187): The ability of the finger joints to move beyond their normal range of motion. Evidence: TAS. Frequency: Occasional (HP:0040283). (ORPHA:488635)
- Cerebellar atrophy (HP:0001272): Cerebellar atrophy is defined as a cerebellum with initially normal structures, in a posterior fossa with normal size, which displays enlarged fissures (interfolial spaces) in comparison to the foliae secondary to loss of tissue. Cerebellar atrophy implies irreversible loss of tissue and result from an ongoing progressive disease until a final stage is reached or a single injury, e.g. an intoxication or infectious event. Evidence: TAS. Frequency: Occasional (HP:0040283). (ORPHA:488635)
- Absent speech (HP:0001344): Complete lack of development of speech and language abilities. Evidence: TAS. Frequency: Occasional (HP:0040283). (ORPHA:488635)
- Intrauterine growth retardation (HP:0001511): An abnormal restriction of fetal growth with fetal weight below the tenth percentile for gestational age. Evidence: TAS. Frequency: Occasional (HP:0040283). (ORPHA:488635)
- Pes planus (HP:0001763): A foot where the longitudinal arch of the foot is in contact with the ground or floor when the individual is standing; or, in a patient lying supine, a foot where the arch is in contact with the surface of a flat board pressed against the sole of the foot by the examiner with a pressure similar to that expected from weight bearing; or, the height of the arch is reduced. Evidence: TAS. Frequency: Occasional (HP:0040283). (ORPHA:488635)
- Bilateral tonic-clonic seizure (HP:0002069): A bilateral tonic-clonic seizure is a seizure defined by a tonic (bilateral increased tone, lasting seconds to minutes) and then a clonic (bilateral sustained rhythmic jerking) phase. Evidence: TAS. Frequency: Occasional (HP:0040283). (ORPHA:488635)
- Drowsiness (HP:0002329): Abnormal feeling of sleepiness or difficulty staying awake. Evidence: TAS. Frequency: Occasional (HP:0040283). (ORPHA:488635)
- Muscle spasm (HP:0003394): Sudden and involuntary contractions of one or more muscles. Evidence: TAS. Frequency: Occasional (HP:0040283). (ORPHA:488635)
- Depressed nasal bridge (HP:0005280): Posterior positioning of the nasal root in relation to the overall facial profile for age. Evidence: TAS. Frequency: Occasional (HP:0040283). (ORPHA:488635)
- Severe demyelination of the white matter (HP:0007258): A severe loss of myelin from nerve fibers in the central nervous system. Evidence: TAS. Frequency: Occasional (HP:0040283). (ORPHA:488635)
- Pes valgus (HP:0008081): An outward (valgus) deviation of the calcaneus relative to the longitudinal axis of the lower leg at the talocalcaneal (subtalar) joint, such that the heel is everted. Evidence: TAS. Frequency: Occasional (HP:0040283). (ORPHA:488635)
- Hypermobility of toe joints (HP:0010510): An ability of the toe joints to move beyond their normal range of motion. Evidence: TAS. Frequency: Occasional (HP:0040283). (ORPHA:488635)
- EEG with focal spikes (HP:0011193): EEG with focal sharp transient waves of a duration less than 80 msec. Evidence: TAS. Frequency: Occasional (HP:0040283). (ORPHA:488635)
- Feeding difficulties (HP:0011968): Impaired ability to eat related to problems gathering food and getting ready to suck, chew, or swallow it. Evidence: TAS. Frequency: Occasional (HP:0040283). (ORPHA:488635)